Phenotypes associated with the disease Tetramelic monodactyly (ORPHA:2564):
- Split hand (HP:0001171): A condition in which middle parts of the hand (fingers and metacarpals) are missing giving a cleft appearance. The severity is very variable ranging from slightly hypoplastic middle fingers over absent middle fingers as far as oligo- or monodactyl hands. Evidence: TAS. Frequency: Very frequent (HP:0040281). (ORPHA:2564)
- Oligodactyly (HP:0012165): A developmental defect resulting in the presence of fewer than the normal number of digits. Evidence: TAS. Frequency: Very frequent (HP:0040281). (ORPHA:2564)